Phenotypes associated with the disease occipital pachygyria and polymicrogyria (OMIM:614115):
- Visual loss (HP:0000572): Loss of visual acuity (implying that vision was better at a certain time point in life). Otherwise the term reduced visual acuity should be used (or a subclass of that). Evidence: PCS. Frequency: 1/3. (PMID:21572413)
- Bilateral tonic-clonic seizure (HP:0002069): A bilateral tonic-clonic seizure is a seizure defined by a tonic (bilateral increased tone, lasting seconds to minutes) and then a clonic (bilateral sustained rhythmic jerking) phase. Evidence: PCS. Frequency: 3/3. (PMID:21572413)
- Juvenile onset (HP:0003621): Onset of signs or symptoms of disease between the age of 5 and 15 years. Evidence: PCS. Frequency: 3/3. (PMID:21572413)
- EEG abnormality (HP:0002353): Abnormality observed by electroencephalogram (EEG), which is used to record of the brain's spontaneous electrical activity from multiple electrodes placed on the scalp. Evidence: PCS. (PMID:21572413)
- Global developmental delay (HP:0001263): A delay in the achievement of motor or mental milestones in the domains of development of a child, including motor skills, speech and language, cognitive skills, and social and emotional skills. This term should only be used to describe children younger than five years of age. Evidence: PCS. Frequency: 1/3. (PMID:21572413)
- Focal impaired awareness automatism seizure (HP:0032909): A focal seizure with automatism in which awareness is partially or fully impaired at some point during the seizure. Evidence: PCS. Frequency: 1/3. (PMID:21572413)
- Autosomal recessive inheritance (HP:0000007): A mode of inheritance that is observed for traits related to a gene encoded on one of the autosomes (i.e., the human chromosomes 1-22) in which a trait manifests in individuals with two pathogenic alleles, either homozygotes (two copies of the same mutant allele) or compound heterozygotes (whereby each copy of a gene has a distinct mutant allele). Evidence: PCS. (PMID:21572413)
- Pachygyria (HP:0001302): Pachygyria is a malformation of cortical development with abnormally wide gyri with sulci 1,5-3 cm apart and abnormally thick cortex measuring more than 5 mm (radiological definition). See also neuropathological definitions for 2-, 3-, and 4-layered lissencephaly. Evidence: PCS. Frequency: 3/3. (PMID:21572413)
- Polymicrogyria (HP:0002126): Polymicrogyria is a congenital malformation of the cerebral cortex characterized by abnormal cortical layering (lamination) and an excessive number of small gyri (folds). Evidence: PCS. Frequency: 3/3. (PMID:21572413)